Phenotypes associated with the disease Bombay phenotype (OMIM:616754):
- Autosomal recessive inheritance (HP:0000007): A mode of inheritance that is observed for traits related to a gene encoded on one of the autosomes (i.e., the human chromosomes 1-22) in which a trait manifests in individuals with two pathogenic alleles, either homozygotes (two copies of the same mutant allele) or compound heterozygotes (whereby each copy of a gene has a distinct mutant allele). Evidence: TAS. (OMIM:616754)